- Micropenis (HP:0000054): Abnormally small penis. At birth, the normal penis is about 3 cm (stretched length from pubic tubercle to tip of penis) with micropenis less than 2.0-2.5 cm. Evidence: PCS. Frequency: 1/6. (PMID:31079898)
- Long face (HP:0000276): Facial height (length) is more than 2 standard deviations above the mean (objective); or, an apparent increase in the height (length) of the face (subjective). Evidence: PCS. Frequency: 2/7. (PMID:31079898)
- Unilateral renal agenesis (HP:0000122): A unilateral form of agenesis of the kidney. Evidence: PCS. Frequency: 1/7. (PMID:31079898)
- Seizure (HP:0001250): A seizure is an intermittent abnormality of nervous system physiology characterized by a transient occurrence of signs and/or symptoms due to abnormal excessive or synchronous neuronal activity in the brain. Evidence: PCS. Frequency: 6/7. (PMID:31079898)
- Deeply set eye (HP:0000490): An eye that is more deeply recessed into the plane of the face than is typical. Evidence: PCS. Frequency: 1/6. (PMID:31079898)
- Global developmental delay (HP:0001263): A delay in the achievement of motor or mental milestones in the domains of development of a child, including motor skills, speech and language, cognitive skills, and social and emotional skills. This term should only be used to describe children younger than five years of age. Evidence: PCS. Frequency: 7/7. (PMID:31079898)
- Prune belly (HP:0004392): A kind of congenital defect of the anterior abdominal wall in which the intestines are evident through the thin, lax, and protruding abdominal wall in affected infants. Evidence: PCS. Frequency: 2/7. Onset: Congenital onset (HP:0003577). (PMID:31079898)
- Abnormally large globe (HP:0001090): Diffusely large eye (with megalocornea) without glaucoma. Evidence: PCS. Frequency: 1/7. (PMID:31079898)
- Increased overbite (HP:0011094): Maxillary teeth cover the mandibular teeth when biting to an increased degree. The feature is defined as a vertical overlap of the maxillary incisors over the mandibular incisors that exceeds 2 mm. Evidence: PCS. Frequency: 1/7. (PMID:31079898)
- Ventricular septal defect (HP:0001629): A hole between the two bottom chambers (ventricles) of the heart. The defect is centered around the most superior aspect of the ventricular septum. Evidence: PCS. Frequency: 1/7. Onset: Congenital onset (HP:0003577). (PMID:31079898)
- Arachnoid granulation (HP:0034454): Arachnoid granulations (AGs) are tufts of arachnoid membrane invaginated into the dural sinuses through which cerebrospinal fluid (CSF) enters the venous system. The lesions are primarily located in the parasagittal region along the superior sagittal sinus, which is occasionally seen at the transverse sinus. Normally dural venous sinus AGs typically range from 2 to 8 mm in size, but may grow enough to expand the dural sinuses, and even the inner table, diploic space and outer table of the skull. Evidence: PCS. Frequency: 1/3. (PMID:31079898)
- Autosomal recessive inheritance (HP:0000007): A mode of inheritance that is observed for traits related to a gene encoded on one of the autosomes (i.e., the human chromosomes 1-22) in which a trait manifests in individuals with two pathogenic alleles, either homozygotes (two copies of the same mutant allele) or compound heterozygotes (whereby each copy of a gene has a distinct mutant allele). Evidence: PCS. (PMID:31079898)
- Motor stereotypy (HP:0000733): Use of the same abnormal action in response to certain triggers or at random. They may be used as a way to regulate one's internal state but must otherwise have no apparent functional purpose. Evidence: PCS. Frequency: 1/6. (PMID:31079898)
- Macrotia (HP:0000400): Median longitudinal ear length greater than two standard deviations above the mean and median ear width greater than two standard deviations above the mean (objective); or, apparent increase in length and width of the pinna (subjective). Evidence: PCS. Frequency: 2/7. (PMID:31079898)
- Attention deficit hyperactivity disorder (HP:0007018): Attention deficit hyperactivity disorder (ADHD) manifests at age 2-3 years or by first grade at the latest. The main symptoms are distractibility, impulsivity, hyperactivity, and often trouble organizing tasks and projects, difficulty going to sleep, and social problems from being aggressive, loud, or impatient. Evidence: PCS. Frequency: 2/7. (PMID:31079898)
- Macrocephaly (HP:0000256): Occipitofrontal (head) circumference greater than 97th centile compared to appropriate, age matched, sex-matched normal standards. Alternatively, a apparently increased size of the cranium. Evidence: PCS. Frequency: 2/7. (PMID:31079898)
- Cryptorchidism (HP:0000028): Testis in inguinal canal. That is, absence of one or both testes from the scrotum owing to failure of the testis or testes to descend through the inguinal canal to the scrotum. Evidence: PCS. Frequency: 1/6. (PMID:31079898)
- Intellectual disability (HP:0001249): The term intellectual disability or intellectual developmental disorder is used to describe significantly sub-average intellectual and adaptive functioning based on clinical assessment and as measured by individually administered, appropriately normed, standardized and validated tests of intellectual functioning and adaptive behavior, with onset during the developmental period from infancy through adolescence. Evidence: PCS. Frequency: 7/7. (PMID:31079898)
These phenotypes are associated with the disease intellectual developmental disorder, autosomal recessive 71 (OMIM:618504).